- Irregularly shaped sperm tail (HP:0033393): Irregular or changing caliber (diameter) along the tail of the sperm. Evidence: PCS. Frequency: 7/7. (PMID:24360805)
- Coiled sperm flagella (HP:0032560): Sperm cells whose flagella are twisted (coiled). Evidence: PCS. Frequency: 7/7. (PMID:24360805)
- Male infertility (HP:0003251). Evidence: PCS. Frequency: 7/7. (PMID:24360805)
- Young adult onset (HP:0011462): Onset of disease at the age of between 16 and 40 years. Evidence: PCS. Frequency: 7/7. (PMID:24360805)
- Autosomal recessive inheritance (HP:0000007): A mode of inheritance that is observed for traits related to a gene encoded on one of the autosomes (i.e., the human chromosomes 1-22) in which a trait manifests in individuals with two pathogenic alleles, either homozygotes (two copies of the same mutant allele) or compound heterozygotes (whereby each copy of a gene has a distinct mutant allele). Evidence: PCS. (PMID:24360805)
- Reduced sperm motility (HP:0012207): An abnormal reduction in the mobility of ejaculated sperm. Evidence: PCS. Frequency: 7/7. (PMID:24360805)
- Absent sperm flagella (HP:0032558): Sperm cells lacking flagella. Evidence: PCS. Frequency: 7/7. (PMID:24360805)
- Short sperm flagella (HP:0032559): Sperm cells with abnormally short flagella. Evidence: PCS. Frequency: 7/7. (PMID:24360805)
These phenotypes are associated with the disease spermatogenic failure 18 (OMIM:617576).